Phenotypes associated with the disease combined oxidative phosphorylation defect type 2 (OMIM:610498):
- Lethargy (HP:0001254): A state of fatigue, either physical or mental slowness and sluggishness, with difficulties in initiating or performing simple tasks. Distinguished from apathy which implies indifference and a lack of desire or interest in the task. A person with lethargy may have the desire, but not the energy to engage in personal or socially relevant tasks. Evidence: PCS. Frequency: 1/1. Onset: Neonatal onset (HP:0003623). (PMID:15505824)
- Congenital onset (HP:0003577): A phenotypic abnormality that is present at birth. Evidence: PCS. Frequency: 1/1. (PMID:15505824)
- Hypokinesia (HP:0002375): Abnormally diminished motor activity. In contrast to paralysis, hypokinesia is not characterized by a lack of motor strength, but rather by a poverty of movement. The typical habitual movements (e.g., folding the arms, crossing the legs) are reduced in frequency. Evidence: PCS. Frequency: 1/1. (PMID:15505824)
- Brachydactyly (HP:0001156): Digits that appear disproportionately short compared to the hand/foot. The word brachydactyly is used here to describe a series distinct patterns of shortened digits (brachydactyly types A-E). This is the sense used here. Evidence: PCS. Frequency: 1/1. (PMID:15505824)
- Decreased activity of mitochondrial complex III (HP:0011924): A reduction in the activity of the mitochondrial respiratory chain complex III, which is part of the electron transport chain in mitochondria. Evidence: PCS. Frequency: 1/1. (PMID:15505824)
- Decreased activity of mitochondrial ATP synthase complex (HP:0011925): A reduction in the activity of the mitochondrial proton-transporting ATP synthase complex, which makes ATP via oxidative phosphorylation, and is sometimes described as Complex V of the electron transport chain. Evidence: PCS. Frequency: 1/1. (PMID:15505824)
- Agenesis of corpus callosum (HP:0001274): Absence of the corpus callosum as a result of the failure of the corpus callosum to develop, which can be the result of a failure in any one of the multiple steps of callosal development including cellular proliferation and migration, axonal growth or glial patterning at the midline. Evidence: PCS. Frequency: 1/1. (PMID:15505824)
- Increased circulating lactate concentration (HP:0002151): Abnormally increased level of blood lactate (2-hydroxypropanoic acid). Lactate is produced from pyruvate by lactate dehydrogenase during normal metabolism. The terms lactate and lactic acid are often used interchangeably but lactate (the component measured in blood) is strictly a weak base whereas lactic acid is the corresponding acid. Lactic acidosis is often used clinically to describe elevated lactate but should be reserved for cases where there is a corresponding acidosis (pH below 7.35). Evidence: PCS. Frequency: 1/1. (PMID:15505824)
- Decreased activity of mitochondrial complex I (HP:0011923): A reduction in the activity of the mitochondrial respiratory chain complex I, which is part of the electron transport chain in mitochondria. Evidence: PCS. Frequency: 1/1. (PMID:15505824)
- Mild fetal ventriculomegaly (HP:0010952): A kind of ventriculomegaly occurring in the fetal period and usually diagnosed by prenatal ultrasound. Cerebral ventriculomegaly is defined by atrial measurements 10 mm or more. Mild ventriculomegaly (MVM) is defined as measurements between 10 and 15 mm. Measurements are obtained from an axial plane at the level of the thalamic nuclei just below the standard image to measure the BPD (PMID:16100637). Evidence: PCS. Frequency: 1/1. Onset: Fetal onset (HP:0011461). (PMID:15505824)
- Edema (HP:0000969): An abnormal accumulation of fluid beneath the skin, or in one or more cavities of the body. Evidence: PCS. Frequency: 1/1. (PMID:15505824)
- Small for gestational age (HP:0001518): Smaller than normal size according to sex and gestational age related norms, defined as a weight below the 10th percentile for the gestational age. Evidence: PCS. Frequency: 1/1. (PMID:15505824)
- Autosomal recessive inheritance (HP:0000007): A mode of inheritance that is observed for traits related to a gene encoded on one of the autosomes (i.e., the human chromosomes 1-22) in which a trait manifests in individuals with two pathogenic alleles, either homozygotes (two copies of the same mutant allele) or compound heterozygotes (whereby each copy of a gene has a distinct mutant allele). Evidence: PCS. (PMID:15505824)
- Feeding difficulties in infancy (HP:0008872): Impaired feeding performance of an infant as manifested by difficulties such as weak and ineffective sucking, brief bursts of sucking, and falling asleep during sucking. There may be difficulties with chewing or maintaining attention. Evidence: PCS. Frequency: 1/1. (PMID:15505824)
- Neonatal hypotonia (HP:0001319): Muscular hypotonia (abnormally low muscle tone) manifesting in the neonatal period. Evidence: PCS. Frequency: 1/1. Onset: Neonatal onset (HP:0003623). (PMID:15505824)
- Decreased activity of mitochondrial complex IV (HP:0008347): A reduction in the activity of the mitochondrial respiratory chain complex IV, which is part of the electron transport chain in mitochondria. Evidence: PCS. Frequency: 1/1. (PMID:15505824)
- Patent ductus arteriosus (HP:0001643): In utero, the ductus arteriosus (DA) serves to divert ventricular output away from the lungs and toward the placenta by connecting the main pulmonary artery to the descending aorta. A patent ductus arteriosus (PDA) in the first 3 days of life is a physiologic shunt in healthy term and preterm newborn infants, and normally is substantially closed within about 24 hours after bith and completely closed after about three weeks. Failure of physiologcal closure is referred to a persistent or patent ductus arteriosus (PDA). Depending on the degree of left-to-right shunting, PDA can have clinical consequences. Evidence: PCS. Frequency: 1/1. (PMID:15505824)
- Neonatal death (HP:0003811): Death within the first 28 days of life. Evidence: PCS. Frequency: 1/1. (PMID:15505824)
- Elevated circulating hepatic transaminase concentration (HP:0002910): Elevations of the levels of SGOT and SGPT in the serum. SGOT (serum glutamic oxaloacetic transaminase) and SGPT (serum glutamic pyruvic transaminase) are transaminases primarily found in the liver and heart and are released into the bloodstream as the result of liver or heart damage. SGOT and SGPT are used clinically mainly as markers of liver damage. Evidence: PCS. Frequency: 1/1. (PMID:15505824)
- Redundant neck skin (HP:0005989): Excess skin around the neck, often lying in horizontal folds. Evidence: PCS. Frequency: 1/1. (PMID:15505824)
- Low-set ears (HP:0000369): Upper insertion of the ear to the scalp below an imaginary horizontal line drawn between the inner canthi of the eye and extending posteriorly to the ear. Evidence: PCS. Frequency: 1/1. (PMID:15505824)
- Lactic acidosis (HP:0003128): An abnormal buildup of lactic acid in the body, leading to acidification of the blood and other bodily fluids. Evidence: PCS. Frequency: 1/1. (PMID:15505824)